- Hypersarcosinemia (HP:0010896): An elevated plasma concentration of sarcosine. Evidence: IEA. (OMIM:268900)
- Autosomal recessive inheritance (HP:0000007): A mode of inheritance that is observed for traits related to a gene encoded on one of the autosomes (i.e., the human chromosomes 1-22) in which a trait manifests in individuals with two pathogenic alleles, either homozygotes (two copies of the same mutant allele) or compound heterozygotes (whereby each copy of a gene has a distinct mutant allele). Evidence: IEA. (OMIM:268900)
These phenotypes are associated with the disease sarcosinemia (OMIM:268900).